- Bilateral tonic-clonic seizure (HP:0002069): A bilateral tonic-clonic seizure is a seizure defined by a tonic (bilateral increased tone, lasting seconds to minutes) and then a clonic (bilateral sustained rhythmic jerking) phase. Evidence: PCS. (PMID:21922598)
- Febrile seizure (within the age range of 3 months to 6 years) (HP:0002373): A febrile seizure is any type of seizure (most often a generalized tonic-clonic seizure) occurring with fever (at least 38 degrees Celsius) but in the absence of central nervous system infection, severe metabolic disturbance or other alternative precipitant in children between the ages of 3 months and 6 years. Evidence: PCS. Frequency: 4/4. (PMID:21922598)
- Focal impaired awareness seizure (HP:0002384): Focal impaired awareness seizure (or focal seizure with impaired or lost awareness) is a type of focal-onset seizure characterized by some degree (which may be partial) of impairment of the person's awareness of themselves or their surroundings at any point during the seizure. Evidence: PCS. Frequency: 1/4. Onset: Young adult onset (HP:0011462). (PMID:21922598)
- Autosomal recessive inheritance (HP:0000007): A mode of inheritance that is observed for traits related to a gene encoded on one of the autosomes (i.e., the human chromosomes 1-22) in which a trait manifests in individuals with two pathogenic alleles, either homozygotes (two copies of the same mutant allele) or compound heterozygotes (whereby each copy of a gene has a distinct mutant allele). Evidence: PCS. (PMID:21922598)
- Hippocampal atrophy (HP:0410170): Partial or complete wasting (loss) of hippocampus tissue that was once present. Evidence: PCS. Frequency: 1/4. (PMID:21922598)
These phenotypes are associated with the disease febrile seizures, familial, 11 (OMIM:614418).